- Patent ductus arteriosus (HP:0001643): In utero, the ductus arteriosus (DA) serves to divert ventricular output away from the lungs and toward the placenta by connecting the main pulmonary artery to the descending aorta. A patent ductus arteriosus (PDA) in the first 3 days of life is a physiologic shunt in healthy term and preterm newborn infants, and normally is substantially closed within about 24 hours after bith and completely closed after about three weeks. Failure of physiologcal closure is referred to a persistent or patent ductus arteriosus (PDA). Depending on the degree of left-to-right shunting, PDA can have clinical consequences. Evidence: PCS. Onset: Congenital onset (HP:0003577). (PMID:27181681)
- Autosomal dominant inheritance (HP:0000006): A mode of inheritance that is observed for traits related to a gene encoded on one of the autosomes (i.e., the human chromosomes 1-22) in which a trait manifests in heterozygotes. In the context of medical genetics, an autosomal dominant disorder is caused when a single copy of the mutant allele is present. Males and females are affected equally, and can both transmit the disorder with a risk of 50% for each child of inheriting the mutant allele. Evidence: PCS. (OMIM:617039)
These phenotypes are associated with the disease patent ductus arteriosus 3 (OMIM:617039).